Phenotypes associated with the disease Schilbach-Rott syndrome (OMIM:164220):
- Submucous cleft hard palate (HP:0000176): Hard-palate submucous clefts are characterized by bony defects in the midline of the bony palate that are covered by the mucous membrane of the roof of the mouth. It may be possible to detect a submucous cleft hard palate upon palpation as a notch in the bony palate. Evidence: IEA. (OMIM:164220)
- 3-4 finger cutaneous syndactyly (HP:0011939): A soft tissue continuity in the A/P axis between fingers 3 and 4. Evidence: TAS. (OMIM:164220)
- Epicanthus (HP:0000286): A fold of skin starting above the medial aspect of the upper eyelid and arching downward to cover, pass in front of and lateral to the medial canthus. Evidence: TAS. (OMIM:164220)
- Upslanted palpebral fissure (HP:0000582): The palpebral fissure inclination is more than two standard deviations above the mean for age (objective); or, the inclination of the palpebral fissure is greater than typical for age. Evidence: IEA. (OMIM:164220)
- Microcephaly (HP:0000252): Head circumference below 2 standard deviations below the mean for age and gender. Evidence: TAS. (OMIM:164220)
- Long nose (HP:0003189): Distance from nasion to subnasale more than two standard deviations above the mean, or alternatively, an apparently increased length from the nasal root to the nasal base. Evidence: TAS. (OMIM:164220)
- Mild intellectual disability (HP:0001256): Mild intellectual disability (ID) is defined as a type of ID characterized by mildly sub-average adaptive functioning and intellectual functioning, with an intelligence quotient (IQ) the range of 50-69. Evidence: TAS. Frequency: Occasional (HP:0040283). (OMIM:164220)
- Short stature (HP:0004322): A height below that which is expected according to age and gender norms. Although there is no universally accepted definition of short stature, many refer to "short stature" as height more than 2 standard deviations below the mean for age and gender (or below the 3rd percentile for age and gender dependent norms). Evidence: TAS. Frequency: Occasional (HP:0040283). (OMIM:164220)
- Bifid uvula (HP:0000193): Uvula separated into two parts most easily seen at the tip. Evidence: TAS. (OMIM:164220)
- Narrow mouth (HP:0000160): Distance between the commissures of the mouth more than 2 SD below the mean. Alternatively, an apparently decreased width of the oral aperture (subjective). Evidence: TAS. (OMIM:164220)
- Blepharophimosis (HP:0000581): A fixed reduction in the vertical distance between the upper and lower eyelids with short palpebral fissures. Evidence: IEA. (OMIM:164220)
- 2-3 toe cutaneous syndactyly (HP:0005709). Evidence: TAS. (OMIM:164220)
- Microtia (HP:0008551): Underdevelopment of the external ear. Evidence: TAS. (OMIM:164220)
- Prominent nose (HP:0000448): Distance between subnasale and pronasale more than two standard deviations above the mean, or alternatively, an apparently increased anterior protrusion of the nasal tip. Evidence: TAS. (OMIM:164220)
- Hypotelorism (HP:0000601): Interpupillary distance less than 2 SD below the mean (alternatively, the appearance of an decreased interpupillary distance or closely spaced eyes). Evidence: IEA. (OMIM:164220)
- Clinodactyly (HP:0030084): An angulation of a digit at an interphalangeal joint in the plane of the palm (finger) or sole (toe). Evidence: TAS. (OMIM:164220)
- Hypospadias (HP:0000047): Abnormal position of urethral meatus on the ventral penile shaft (underside) characterized by displacement of the urethral meatus from the tip of the glans penis to the ventral surface of the penis, scrotum, or perineum. Evidence: IEA. (OMIM:164220)
- Attention deficit hyperactivity disorder (HP:0007018): Attention deficit hyperactivity disorder (ADHD) manifests at age 2-3 years or by first grade at the latest. The main symptoms are distractibility, impulsivity, hyperactivity, and often trouble organizing tasks and projects, difficulty going to sleep, and social problems from being aggressive, loud, or impatient. Evidence: TAS. (OMIM:164220)
- Autosomal dominant inheritance (HP:0000006): A mode of inheritance that is observed for traits related to a gene encoded on one of the autosomes (i.e., the human chromosomes 1-22) in which a trait manifests in heterozygotes. In the context of medical genetics, an autosomal dominant disorder is caused when a single copy of the mutant allele is present. Males and females are affected equally, and can both transmit the disorder with a risk of 50% for each child of inheriting the mutant allele. Evidence: IEA. (OMIM:164220)
- Posteriorly rotated ears (HP:0000358): A type of abnormal location of the ears in which the position of the ears is characterized by posterior rotation (the superior part of the ears is rotated towards the back of the head, and the inferior part of the ears towards the front). Evidence: TAS. (OMIM:164220)
- Micrognathia (HP:0000347): Developmental hypoplasia of the mandible. Evidence: TAS. (OMIM:164220)